Phenotypes associated with the disease angioedema, hereditary, 6 (OMIM:619363):
- Middle age onset (HP:0003596): A type of adult onset with onset of symptoms at the age of 40 to 60 years. Evidence: PCS. Frequency: 2/6. (PMID:31087670)
- Angioedema (HP:0100665): Rapid swelling (edema) of the dermis, subcutaneous tissue, mucosa and submucosal tissues of the skin of the face, normally around the mouth, and the mucosa of the mouth and/or throat, as well as the tongue during a period of minutes to several hours. The swelling can also occur elsewhere, typically in the hands. Angioedema is similar to urticaria, but the swelling is subcutaneous rather than on the epidermis. Evidence: PCS. Frequency: 6/6. (PMID:31087670)
- Facial edema (HP:0000282). Evidence: PCS. Frequency: 5/6. (PMID:31087670)
- Young adult onset (HP:0011462): Onset of disease at the age of between 16 and 40 years. Evidence: IEA. Frequency: 4/6. (PMID:31087670)
- Swollen lip (HP:0031244): Enlargement of the lip typically due to fluid buildup or inflammation. Evidence: PCS. Frequency: 5/6. (PMID:31087670)
- Autosomal dominant inheritance (HP:0000006): A mode of inheritance that is observed for traits related to a gene encoded on one of the autosomes (i.e., the human chromosomes 1-22) in which a trait manifests in heterozygotes. In the context of medical genetics, an autosomal dominant disorder is caused when a single copy of the mutant allele is present. Males and females are affected equally, and can both transmit the disorder with a risk of 50% for each child of inheriting the mutant allele. Evidence: TAS. (PMID:31087670)
- Edema of the dorsum of hands (HP:0007514): An abnormal accumulation of fluid beneath the skin on the back of the hands. Evidence: PCS. Frequency: 2/6. (PMID:31087670)